- Abnormality of the vertebral column (HP:0000925): Any abnormality of the vertebral column. Evidence: IEA. (OMIM:601884)
- Increased spinal bone density (HP:0004563): Increased bone density affecting the bones of the spine (vertebral column). Evidence: IEA. (OMIM:601884)
- Autosomal dominant inheritance (HP:0000006): A mode of inheritance that is observed for traits related to a gene encoded on one of the autosomes (i.e., the human chromosomes 1-22) in which a trait manifests in heterozygotes. In the context of medical genetics, an autosomal dominant disorder is caused when a single copy of the mutant allele is present. Males and females are affected equally, and can both transmit the disorder with a risk of 50% for each child of inheriting the mutant allele. Evidence: IEA. (OMIM:601884)
These phenotypes are associated with the disease BONE MINERAL DENSITY QUANTITATIVE TRAIT LOCUS 1 (OMIM:601884).